- Hyperextensible thumb (HP:0005722): The ability of the thumb joints to move beyond their normal range of motion. Evidence: IEA. (OMIM:274200)
- Autosomal recessive inheritance (HP:0000007): A mode of inheritance that is observed for traits related to a gene encoded on one of the autosomes (i.e., the human chromosomes 1-22) in which a trait manifests in individuals with two pathogenic alleles, either homozygotes (two copies of the same mutant allele) or compound heterozygotes (whereby each copy of a gene has a distinct mutant allele). Evidence: IEA. (OMIM:274200)
These phenotypes are associated with the disease thumb, distal hyperextensibility of (OMIM:274200).